- Pruritus (HP:0000989): Pruritus is an itch or a sensation that makes a person want to scratch. This term refers to an abnormally increased disposition to experience pruritus. Evidence: TAS. Frequency: Very frequent (HP:0040281). (ORPHA:49804)
- Papule (HP:0200034): A circumscribed, solid elevation of skin with no visible fluid, varying in size from a pinhead to less than 10mm in diameter at the widest point. Evidence: TAS. Frequency: Very frequent (HP:0040281). (ORPHA:49804)
These phenotypes are associated with the disease Lichen amyloidosis (ORPHA:49804).